- Epicanthus (HP:0000286): A fold of skin starting above the medial aspect of the upper eyelid and arching downward to cover, pass in front of and lateral to the medial canthus. Evidence: PCS. Frequency: 2/7. (PMID:29429572)
- Strabismus (HP:0000486): A misalignment of the eyes so that the visual axes deviate from bifoveal fixation. The classification of strabismus may be based on a number of features including the relative position of the eyes, whether the deviation is latent or manifest, intermittent or constant, concomitant or otherwise and according to the age of onset and the relevance of any associated refractive error. Evidence: PCS. Frequency: 2/8. (PMID:29429572)
- Hearing impairment (HP:0000365): A decreased magnitude of the sensory perception of sound. Evidence: PCS. Frequency: 4/8. (PMID:29429572)
- Trigonocephaly (HP:0000243): Wedge-shaped, or triangular head, with the apex of the triangle at the midline of the forehead and the base of the triangle at the occiput. Evidence: PCS. Frequency: 1/8. (PMID:29429572)
- Short stature (HP:0004322): A height below that which is expected according to age and gender norms. Although there is no universally accepted definition of short stature, many refer to "short stature" as height more than 2 standard deviations below the mean for age and gender (or below the 3rd percentile for age and gender dependent norms). Evidence: PCS. Frequency: 4/8. (PMID:29429572)
- Sagittal craniosynostosis (HP:0004442): A kind of craniosynostosis affecting the sagittal suture. Evidence: PCS. Frequency: 2/8. (PMID:29429572)
- Hypotonia (HP:0001252): Hypotonia is an abnormally low muscle tone (the amount of tension or resistance to movement in a muscle). Even when relaxed, muscles have a continuous and passive partial contraction which provides some resistance to passive stretching. Hypotonia thus manifests as diminished resistance to passive stretching. Hypotonia is not the same as muscle weakness, although the two conditions can co-exist. Evidence: PCS. Frequency: 4/7. (PMID:29429572)
- Hypoplastic fifth toenail (HP:0011937): Underdeveloped nails of the fifth toes. Evidence: PCS. Frequency: 8/8. (PMID:29429572)
- Infantile onset (HP:0003593): Onset of signs or symptoms of disease between 28 days to one year of life. Evidence: PCS. (PMID:29429572)
- Coarse facial features (HP:0000280): Absence of fine and sharp appearance of brows, nose, lips, mouth, and chin, usually because of rounded and heavy features or thickened skin with or without thickening of subcutaneous and bony tissues. Evidence: PCS. Frequency: 2/8. (PMID:29429572)
- Prominent forehead (HP:0011220): Forward prominence of the entire forehead, due to protrusion of the frontal bone. Evidence: PCS. Frequency: 5/8. (PMID:29429572)
- Hypertelorism (HP:0000316): Interpupillary distance more than 2 SD above the mean (alternatively, the appearance of an increased interpupillary distance or widely spaced eyes). Evidence: PCS. Frequency: 2/8. (PMID:29429572)
- Bicuspid aortic valve (HP:0001647): The presence of an aortic valve with two instead of the normal three cusps (flaps). Bicuspid aortic valvue is a malformation of a commissure (small space between the attachment of each cusp to the aortic wall) and the adjacent parts of the two corresponding cusps forming a raphe (the fused area of the two underdeveloped cusps turning into a malformed commissure between both cusps; the raphe is a fibrous ridge that extends from the commissure to the free edge of the two underdeveloped, conjoint cusps). Evidence: PCS. Frequency: 1/8. (PMID:29429572)
- Hyperactivity (HP:0000752): Hyperactivity is a condition characterized by constant and unusually high levels of activity, even in situations where it is deemed inappropriate. Evidence: PCS. Frequency: 1/8. (PMID:29429572)
- Constipation (HP:0002019): Infrequent or difficult evacuation of feces. Evidence: PCS. Frequency: 6/8. (PMID:29429572)
- Posteriorly rotated ears (HP:0000358): A type of abnormal location of the ears in which the position of the ears is characterized by posterior rotation (the superior part of the ears is rotated towards the back of the head, and the inferior part of the ears towards the front). Evidence: PCS. Frequency: 3/8. (PMID:29429572)
- Intellectual disability (HP:0001249): The term intellectual disability or intellectual developmental disorder is used to describe significantly sub-average intellectual and adaptive functioning based on clinical assessment and as measured by individually administered, appropriately normed, standardized and validated tests of intellectual functioning and adaptive behavior, with onset during the developmental period from infancy through adolescence. Evidence: PCS. Frequency: 7/7. (PMID:29429572)
- Downslanted palpebral fissures (HP:0000494): The palpebral fissure inclination is more than two standard deviations below the mean. Evidence: PCS. Frequency: 6/7. (PMID:29429572)
- Thick nasal alae (HP:0009928): Increase in bulk of the ala nasi. Evidence: PCS. Frequency: 5/8. (PMID:29429572)
- Thick eyebrow (HP:0000574): Increased density/number and/or increased diameter of eyebrow hairs. Evidence: PCS. Frequency: 3/7. (PMID:29429572)
- Feeding difficulties (HP:0011968): Impaired ability to eat related to problems gathering food and getting ready to suck, chew, or swallow it. Evidence: PCS. Frequency: 5/8. (PMID:29429572)
- Microdontia (HP:0000691): Decreased size of the teeth, which can be defined as a mesiodistal tooth diameter (width) more than 2 SD below mean. Alternatively, an apparently decreased maximum width of tooth. Evidence: PCS. Frequency: 2/7. (PMID:29429572)
- Global developmental delay (HP:0001263): A delay in the achievement of motor or mental milestones in the domains of development of a child, including motor skills, speech and language, cognitive skills, and social and emotional skills. This term should only be used to describe children younger than five years of age. Evidence: PCS. Frequency: 8/8. (PMID:29429572)
- Pectus excavatum (HP:0000767): A defect of the chest wall characterized by a depression of the sternum, giving the chest ("pectus") a caved-in ("excavatum") appearance. Evidence: PCS. Frequency: 2/8. (PMID:29429572)
- Recurrent otitis media (HP:0000403): Increased susceptibility to otitis media, as manifested by recurrent episodes of otitis media. Evidence: PCS. Frequency: 4/6. (PMID:29429572)
- Compulsive behaviors (HP:0000722): Behavior that consists of repetitive acts, characterized by the feeling that one "has to" perform them, while being aware that these acts are not in line with one's overall goal. Evidence: PCS. Frequency: 1/8. (PMID:29429572)
- Clinodactyly of the 5th finger (HP:0004209): Clinodactyly refers to a bending or curvature of the fifth finger in the radial direction (i.e., towards the 4th finger). Evidence: PCS. Frequency: 3/8. (PMID:29429572)
- Macrotia (HP:0000400): Median longitudinal ear length greater than two standard deviations above the mean and median ear width greater than two standard deviations above the mean (objective); or, apparent increase in length and width of the pinna (subjective). Evidence: PCS. Frequency: 3/8. (PMID:29429572)
- Convex nasal ridge (HP:0000444): Nasal ridge curving anteriorly to an imaginary line that connects the nasal root and tip. The nose appears often also prominent, and the columella low. Evidence: PCS. Frequency: 1/8. (PMID:29429572)
- Short philtrum (HP:0000322): Distance between nasal base and midline upper lip vermilion border more than 2 SD below the mean. Alternatively, an apparently decreased distance between nasal base and midline upper lip vermilion border. Evidence: PCS. Frequency: 4/8. (PMID:29429572)
- Broad philtrum (HP:0000289): Distance between the philtral ridges, measured just above the vermilion border, more than 2 standard deviations above the mean, or alternatively, an apparently increased distance between the ridges of the philtrum. Evidence: PCS. Frequency: 3/8. (PMID:29429572)
- Low-set ears (HP:0000369): Upper insertion of the ear to the scalp below an imaginary horizontal line drawn between the inner canthi of the eye and extending posteriorly to the ear. Evidence: PCS. Frequency: 4/7. (PMID:29429572)
- Autosomal dominant inheritance (HP:0000006): A mode of inheritance that is observed for traits related to a gene encoded on one of the autosomes (i.e., the human chromosomes 1-22) in which a trait manifests in heterozygotes. In the context of medical genetics, an autosomal dominant disorder is caused when a single copy of the mutant allele is present. Males and females are affected equally, and can both transmit the disorder with a risk of 50% for each child of inheriting the mutant allele. Evidence: PCS. (PMID:29429572)
- Wide nose (HP:0000445): Interalar distance more than two standard deviations above the mean for age, i.e., an apparently increased width of the nasal base and alae. Evidence: PCS. Frequency: 4/8. (PMID:29429572)
- Patent foramen ovale (HP:0001655): Failure of the foramen ovale to seal postnatally, leaving a potential conduit between the left and right cardiac atria. Evidence: PCS. Frequency: 1/8. (PMID:29429572)
- Hypermetropia (HP:0000540): An abnormality of refraction characterized by the ability to see objects in the distance clearly, while objects nearby appear blurry. Evidence: PCS. Frequency: 1/8. (PMID:29429572)
- Brachydactyly (HP:0001156): Digits that appear disproportionately short compared to the hand/foot. The word brachydactyly is used here to describe a series distinct patterns of shortened digits (brachydactyly types A-E). This is the sense used here. Evidence: PCS. Frequency: 5/8. (PMID:29429572)
- Anteverted nares (HP:0000463): Anteriorly-facing nostrils viewed with the head in the Frankfurt horizontal and the eyes of the observer level with the eyes of the subject. This gives the appearance of an upturned nose (upturned nasal tip). Evidence: PCS. Frequency: 1/8. (PMID:29429572)
- Single umbilical artery (HP:0001195): Single umbilical artery (SUA) is the absence of one of the two umbilical arteries surrounding the fetal bladder and in the fetal umbilical cord. Evidence: PCS. Frequency: 1/8. (PMID:29429572)
- Motor delay (HP:0001270): A type of Developmental delay characterized by a delay in acquiring motor skills. Evidence: PCS. Frequency: 5/8. (PMID:29429572)
- Severe temper tantrums (HP:0025162): Temper tantrums, which occur with more severe symptomatology compared to a temper tantrum that occurs as a part of normal developmental process. Evidence: PCS. Frequency: 2/8. (PMID:29429572)
- Ventricular septal defect (HP:0001629): A hole between the two bottom chambers (ventricles) of the heart. The defect is centered around the most superior aspect of the ventricular septum. Evidence: PCS. Frequency: 1/8. (PMID:29429572)
- Motor stereotypy (HP:0000733): Use of the same abnormal action in response to certain triggers or at random. They may be used as a way to regulate one's internal state but must otherwise have no apparent functional purpose. Evidence: PCS. Frequency: 2/8. (PMID:29429572)
- Thin upper lip vermilion (HP:0000219): Height of the vermilion of the upper lip in the midline more than 2 SD below the mean. Alternatively, an apparently reduced height of the vermilion of the upper lip in the frontal view (subjective). Evidence: PCS. Frequency: 4/8. (PMID:29429572)
- Downturned corners of mouth (HP:0002714): A morphological abnormality of the mouth in which the angle of the mouth is downturned. The oral commissures are positioned inferior to the midline labial fissure. Evidence: PCS. Frequency: 1/8. (PMID:29429572)
- Thick lower lip vermilion (HP:0000179): Increased thickness of the lower lip, leading to a prominent appearance of the lower lip. The height of the vermilion of the lower lip in the midline is more than 2 SD above the mean. Alternatively, an apparently increased height of the vermilion of the lower lip in the frontal view (subjective). Evidence: PCS. Frequency: 4/8. (PMID:29429572)
- Wide mouth (HP:0000154): Distance between the oral commissures more than 2 SD above the mean. Alternatively, an apparently increased width of the oral aperture (subjective). Evidence: PCS. Frequency: 4/8. (PMID:29429572)
- Oligohydramnios (HP:0001562): Diminished amniotic fluid volume in pregnancy. Evidence: PCS. Frequency: 1/8. (PMID:29429572)
- Polyhydramnios (HP:0001561): The presence of excess amniotic fluid in the uterus during pregnancy. Evidence: PCS. Frequency: 1/8. (PMID:29429572)
- Delayed speech and language development (HP:0000750): A degree of language development that is significantly below the norm for a child of a specified age. Evidence: PCS. Frequency: 8/8. (PMID:29429572)
- Delayed ability to walk (HP:0031936): A failure to achieve the ability to walk at an appropriate developmental stage. Most children learn to walk in a series of stages, and learn to walk short distances independently between 12 and 15 months. Evidence: PCS. Frequency: 6/8. (PMID:29429572)
- Depressed nasal bridge (HP:0005280): Posterior positioning of the nasal root in relation to the overall facial profile for age. Evidence: PCS. Frequency: 3/8. (PMID:29429572)
- Chiari type I malformation (HP:0007099): Arnold-Chiari type I malformation refers to a relatively mild degree of herniation of the posteroinferior region of the cerebellum (the cerebellar tonsils) into the cervical canal with little or no displacement of the fourth ventricle. It is characterized by one or both pointed (not rounded) cerebellar tonsils that project 5 mm below the foramen magnum, measured by a line drawn from the basion to the opisthion (McRae Line). Evidence: PCS. Frequency: 1/8. (PMID:29429572)
- Sparse scalp hair (HP:0002209): Decreased number of hairs per unit area of skin of the scalp. Evidence: PCS. Frequency: 6/7. (PMID:29429572)
These phenotypes are associated with the disease Coffin-Siris syndrome 7 (OMIM:618027).